Phenotypes associated with the disease Dentinogenesis imperfecta-short stature-hearing loss-intellectual disability syndrome (ORPHA:71267):
- Short philtrum (HP:0000322): Distance between nasal base and midline upper lip vermilion border more than 2 SD below the mean. Alternatively, an apparently decreased distance between nasal base and midline upper lip vermilion border. Evidence: TAS. Frequency: Very frequent (HP:0040281). (ORPHA:71267)
- Sensorineural hearing impairment (HP:0000407): A type of hearing impairment in one or both ears related to an abnormal functionality of the cochlear nerve. Evidence: TAS. Frequency: Very frequent (HP:0040281). (ORPHA:71267)
- Prominent nasal bridge (HP:0000426): Anterior positioning of the nasal root in comparison to the usual positioning for age. Evidence: TAS. Frequency: Very frequent (HP:0040281). (ORPHA:71267)
- Delayed eruption of teeth (HP:0000684): Delayed tooth eruption, which can be defined as tooth eruption more than 2 SD beyond the mean eruption age. Evidence: TAS. Frequency: Very frequent (HP:0040281). (ORPHA:71267)
- Dentinogenesis imperfecta (HP:0000703): Developmental dysplasia of dentin. Evidence: TAS. Frequency: Very frequent (HP:0040281). (ORPHA:71267)
- Platyspondyly (HP:0000926): A flattened vertebral body shape with reduced distance between the vertebral endplates. Evidence: TAS. Frequency: Very frequent (HP:0040281). (ORPHA:71267)
- Osteoporosis (HP:0000939): Osteoporosis is a systemic skeletal disease characterized by low bone density and microarchitectural deterioration of bone tissue with a consequent increase in bone fragility. According to the WHO criteria, osteoporosis is defined as a BMD that lies 2.5 standard deviations or more below the average value for young healthy adults (a T-score below -2.5 SD). Evidence: TAS. Frequency: Very frequent (HP:0040281). (ORPHA:71267)
- Mild intellectual disability (HP:0001256): Mild intellectual disability (ID) is defined as a type of ID characterized by mildly sub-average adaptive functioning and intellectual functioning, with an intelligence quotient (IQ) the range of 50-69. Evidence: TAS. Frequency: Very frequent (HP:0040281). (ORPHA:71267)
- Abnormal facial shape (HP:0001999): An abnormal morphology (form) of the face or its components. Evidence: TAS. Frequency: Very frequent (HP:0040281). (ORPHA:71267)
- Short stature (HP:0004322): A height below that which is expected according to age and gender norms. Although there is no universally accepted definition of short stature, many refer to "short stature" as height more than 2 standard deviations below the mean for age and gender (or below the 3rd percentile for age and gender dependent norms). Evidence: TAS. Frequency: Very frequent (HP:0040281). (ORPHA:71267)
- Cone-shaped epiphysis (HP:0010579): Cone-shaped epiphyses (also known as coned epiphyses) are epiphyses that invaginate into cupped metaphyses. That is, the epiphysis has a cone-shaped distal extension resulting from increased growth of the central portion of the epiphysis relative to its periphery. Evidence: TAS. Frequency: Very frequent (HP:0040281). (ORPHA:71267)